Phenotypes associated with the disease Microcornea-glaucoma-absent frontal sinuses syndrome (ORPHA:2536):
- Epicanthus (HP:0000286): A fold of skin starting above the medial aspect of the upper eyelid and arching downward to cover, pass in front of and lateral to the medial canthus. Evidence: TAS. Frequency: Frequent (HP:0040282). (ORPHA:2536)
- Round face (HP:0000311): The facial appearance is more circular than usual as viewed from the front. Evidence: TAS. Frequency: Frequent (HP:0040282). (ORPHA:2536)
- Microcornea (HP:0000482): A congenital abnormality of the cornea in which the cornea and the anterior segment of the eye are smaller than normal. The horizontal diameter of the cornea does not reach 10 mm even in adulthood. Evidence: TAS. Frequency: Very frequent (HP:0040281). (ORPHA:2536)
- Glaucoma (HP:0000501): Glaucoma refers loss of retinal ganglion cells in a characteristic pattern of optic neuropathy usually associated with increased intraocular pressure. Evidence: TAS. Frequency: Very frequent (HP:0040281). (ORPHA:2536)
- Visual impairment (HP:0000505): Visual impairment (or vision impairment) is vision loss (of a person) to such a degree as to qualify as an additional support need through a significant limitation of visual capability resulting from either disease, trauma, or congenital or degenerative conditions that cannot be corrected by conventional means, such as refractive correction, medication, or surgery. Evidence: TAS. Frequency: Frequent (HP:0040282). (ORPHA:2536)
- Abnormal skull morphology (HP:0000929): An abnormality of the skull, the bony framework of the head which is comprised of the neurocranium (with eight cranial bones) and the viscerocranium (facial skeleton) that comprises fourteen facial bones with the mandible as its largest bone. Evidence: TAS. Frequency: Very frequent (HP:0040281). (ORPHA:2536)
- Palmoplantar keratoderma (HP:0000982): Abnormal thickening of the skin of the palms of the hands and the soles of the feet. Evidence: TAS. Frequency: Very frequent (HP:0040281). (ORPHA:2536)
- Absent frontal sinuses (HP:0002688): Aplasia of frontal sinus. Evidence: TAS. Frequency: Very frequent (HP:0040281). (ORPHA:2536)
- Flat face (HP:0012368): Absence of concavity or convexity of the face when viewed in profile. Evidence: TAS. Frequency: Frequent (HP:0040282). (ORPHA:2536)
- Torus palatinus (HP:0100789): A bony protrusion present on the midline of the hard palate. Evidence: TAS. Frequency: Very frequent (HP:0040281). (ORPHA:2536)